Phenotypes associated with the disease congenital unilateral hypoplasia of depressor anguli oris (OMIM:125520):
- Congenital onset (HP:0003577): A phenotypic abnormality that is present at birth. Evidence: TAS. (OMIM:125520)
- Ventricular septal defect (HP:0001629): A hole between the two bottom chambers (ventricles) of the heart. The defect is centered around the most superior aspect of the ventricular septum. Evidence: TAS. (OMIM:125520)
- Tetralogy of Fallot (HP:0001636): A congenital cardiac malformation comprising pulmonary stenosis, overriding aorta, ventricular septum defect, and right ventricular hypertrophy. The diagnosis of TOF is made if at least three of the four above mentioned features are present. Evidence: TAS. (OMIM:125520)
- Asymmetric crying face (HP:0011333): Asymmetry observed in the face of a neonate or infant whose face appears symmetric at rest and asymmetric during crying as the mouth is pulled downward on one side while not moving on the other side. Evidence: TAS. (OMIM:125520)
- Patent ductus arteriosus (HP:0001643): In utero, the ductus arteriosus (DA) serves to divert ventricular output away from the lungs and toward the placenta by connecting the main pulmonary artery to the descending aorta. A patent ductus arteriosus (PDA) in the first 3 days of life is a physiologic shunt in healthy term and preterm newborn infants, and normally is substantially closed within about 24 hours after bith and completely closed after about three weeks. Failure of physiologcal closure is referred to a persistent or patent ductus arteriosus (PDA). Depending on the degree of left-to-right shunting, PDA can have clinical consequences. Evidence: TAS. (OMIM:125520)
- Autosomal dominant inheritance (HP:0000006): A mode of inheritance that is observed for traits related to a gene encoded on one of the autosomes (i.e., the human chromosomes 1-22) in which a trait manifests in heterozygotes. In the context of medical genetics, an autosomal dominant disorder is caused when a single copy of the mutant allele is present. Males and females are affected equally, and can both transmit the disorder with a risk of 50% for each child of inheriting the mutant allele. Evidence: TAS. (OMIM:125520)